- Upslanted palpebral fissure (HP:0000582): The palpebral fissure inclination is more than two standard deviations above the mean for age (objective); or, the inclination of the palpebral fissure is greater than typical for age. Evidence: PCS. Frequency: 3/8. (PMID:24721225)
- Strabismus (HP:0000486): A misalignment of the eyes so that the visual axes deviate from bifoveal fixation. The classification of strabismus may be based on a number of features including the relative position of the eyes, whether the deviation is latent or manifest, intermittent or constant, concomitant or otherwise and according to the age of onset and the relevance of any associated refractive error. Evidence: PCS. Frequency: 3/8. (PMID:24721225)
- Delayed speech and language development (HP:0000750): A degree of language development that is significantly below the norm for a child of a specified age. Evidence: PCS. Frequency: 7/7. (PMID:24721225)
- Seizure (HP:0001250): A seizure is an intermittent abnormality of nervous system physiology characterized by a transient occurrence of signs and/or symptoms due to abnormal excessive or synchronous neuronal activity in the brain. Evidence: PCS. Frequency: 1/8. (PMID:24721225)
- Bifid uvula (HP:0000193): Uvula separated into two parts most easily seen at the tip. Evidence: PCS. Frequency: 1/8. (PMID:24721225)
- Global developmental delay (HP:0001263): A delay in the achievement of motor or mental milestones in the domains of development of a child, including motor skills, speech and language, cognitive skills, and social and emotional skills. This term should only be used to describe children younger than five years of age. Evidence: PCS. (PMID:24721225)
- Hypotonia (HP:0001252): Hypotonia is an abnormally low muscle tone (the amount of tension or resistance to movement in a muscle). Even when relaxed, muscles have a continuous and passive partial contraction which provides some resistance to passive stretching. Hypotonia thus manifests as diminished resistance to passive stretching. Hypotonia is not the same as muscle weakness, although the two conditions can co-exist. Evidence: PCS. Frequency: 3/8. (PMID:24721225)
- Malar flattening (HP:0000272): Underdevelopment of the malar prominence of the jugal bone (zygomatic bone in mammals), appreciated in profile, frontal view, and/or by palpation. Evidence: PCS. Frequency: 3/8. (PMID:24721225)
- Motor delay (HP:0001270): A type of Developmental delay characterized by a delay in acquiring motor skills. Evidence: PCS. Frequency: 6/6. (PMID:24721225)
- X-linked recessive inheritance (HP:0001419): A mode of inheritance that is observed for recessive traits related to a gene encoded on the X chromosome. In the context of medical genetics, X-linked recessive disorders manifest in males (who have one copy of the X chromosome and are thus hemizygotes), but generally not in female heterozygotes who have one mutant and one normal allele. Evidence: PCS. (PMID:24721225)
- Enuresis (HP:0000805): Lack of the ability to control the urinary bladder leading to involuntary urination at an age where control of the bladder should already be possible. Evidence: PCS. Frequency: 4/8. (PMID:24721225)
- X-linked inheritance (HP:0001417): A mode of inheritance that is observed for traits related to a gene encoded on the X chromosome. Evidence: PCS. Frequency: 14/14. (PMID:15185169)
- High palate (HP:0000218): Height of the palate more than 2 SD above the mean (objective) or palatal height at the level of the first permanent molar more than twice the height of the teeth (subjective). Evidence: PCS. Frequency: 3/8. (PMID:24721225)
- Narrow chest (HP:0000774): Reduced width of the chest from side to side, associated with a reduced distance from the sternal notch to the tip of the shoulder. Evidence: PCS. Frequency: 3/8. (PMID:24721225)
- Attention deficit hyperactivity disorder (HP:0007018): Attention deficit hyperactivity disorder (ADHD) manifests at age 2-3 years or by first grade at the latest. The main symptoms are distractibility, impulsivity, hyperactivity, and often trouble organizing tasks and projects, difficulty going to sleep, and social problems from being aggressive, loud, or impatient. Evidence: PCS. Frequency: 3/6. (PMID:24721225)
- Intellectual disability (HP:0001249): The term intellectual disability or intellectual developmental disorder is used to describe significantly sub-average intellectual and adaptive functioning based on clinical assessment and as measured by individually administered, appropriately normed, standardized and validated tests of intellectual functioning and adaptive behavior, with onset during the developmental period from infancy through adolescence. Evidence: PCS. Frequency: 18/18. (PMID:15185169;PMID:24721225)
These phenotypes are associated with the disease intellectual disability, X-linked 90 (OMIM:300850).